Phenotypes associated with the disease Delta-beta-thalassemia (ORPHA:231237):
- Anemia (HP:0001903): A reduction in erythrocytes volume or hemoglobin concentration. Evidence: TAS. Frequency: Very frequent (HP:0040281). (ORPHA:231237)
- Microcytic anemia (HP:0001935): A kind of anemia in which the volume of the red blood cells is reduced. Evidence: TAS. Frequency: Very frequent (HP:0040281). (ORPHA:231237)
- Abnormal hemoglobin (HP:0011902): Anomaly in the level or the function of hemoglobin, the oxygen-carrying protein of erythrocytes. Evidence: TAS. Frequency: Very frequent (HP:0040281). (ORPHA:231237)